- Rhizomelia (HP:0008905): Disproportionate shortening of the proximal segment of limbs (i.e. the femur and humerus). Evidence: TAS. Frequency: Very frequent (HP:0040281). (ORPHA:63259)
- Spinal dysraphism (HP:0010301): A heterogeneous group of congenital spinal anomalies that result from defective closure of the neural tube early in fetal life. Evidence: TAS. Frequency: Very frequent (HP:0040281). (ORPHA:63259)
- Narrow mouth (HP:0000160): Distance between the commissures of the mouth more than 2 SD below the mean. Alternatively, an apparently decreased width of the oral aperture (subjective). Evidence: TAS. Frequency: Frequent (HP:0040282). (ORPHA:63259)
- Low-set ears (HP:0000369): Upper insertion of the ear to the scalp below an imaginary horizontal line drawn between the inner canthi of the eye and extending posteriorly to the ear. Evidence: TAS. Frequency: Frequent (HP:0040282). (ORPHA:63259)
- Holoprosencephaly (HP:0001360): Holoprosencephaly is a structural anomaly of the brain in which the developing forebrain fails to divide into two separate hemispheres and ventricles. Evidence: TAS. Frequency: Frequent (HP:0040282). (ORPHA:63259)
- Gastroschisis (HP:0001543): A type of congenital ventral incomplete closure of the abdominal wall in which the intestines and sometimes other organs extend freely into the amniotic fluid space through a small opening in the abdomen, usually to the right of the umbilicus. Evidence: TAS. Frequency: Frequent (HP:0040282). (ORPHA:63259)
- Polyhydramnios (HP:0001561): The presence of excess amniotic fluid in the uterus during pregnancy. Evidence: TAS. Frequency: Frequent (HP:0040282). (ORPHA:63259)
- Rocker bottom foot (HP:0001838): The presence of both a prominent heel and a convex contour of the sole. Evidence: TAS. Frequency: Frequent (HP:0040282). (ORPHA:63259)
- Anencephaly (HP:0002323): Anencephaly is a developmental anomaly characterized by a fetus that has no calvarium, with a lack of most or all of the fetus' brain tissue. Anencephaly belongs to a collective group known as neural tube defects (NTD) and is a result of the neural tube failing to close in its rostral end during fetal development. Evidence: TAS. Frequency: Frequent (HP:0040282). (ORPHA:63259)
- Spina bifida (HP:0002414): Incomplete closure of the embryonic neural tube, whereby some vertebral arches remain unfused and open. The mildest form is spina bifida occulta, followed by meningocele and meningomyelocele. Evidence: TAS. Frequency: Frequent (HP:0040282). (ORPHA:63259)
- Hyperlordosis (HP:0003307): Abnormally increased curvature (anterior concavity) of the lumbar or cervical spine. Evidence: TAS. Frequency: Frequent (HP:0040282). (ORPHA:63259)
- Absent vertebra (HP:0008465): A developmental defect characterized by agenesis of one or more vertebral bodies. Evidence: TAS. Frequency: Frequent (HP:0040282). (ORPHA:63259)
- Mandibular aplasia (HP:0009939): Absence of the mandible. Evidence: TAS. Frequency: Frequent (HP:0040282). (ORPHA:63259)
- Abnormal cardiovascular system morphology (HP:0030680): Any structural anomaly of the heart and blood vessels. Evidence: TAS. Frequency: Frequent (HP:0040282). (ORPHA:63259)
- Abnormality of the genital system (HP:0000078): An abnormality of the genital system. Evidence: TAS. Frequency: Occasional (HP:0040283). (ORPHA:63259)
- Renal agenesis (HP:0000104): Agenesis, that is, failure of the kidney to develop during embryogenesis and development. Evidence: TAS. Frequency: Occasional (HP:0040283). (ORPHA:63259)
- Orofacial cleft (HP:0000202): The presence of a cleft (gap, opening, or groove) in the oral cavity, including cleft of the upper lip and/or cleft of the palate. Cleft of the upper lip is visible as a groove or fissure in the lip, most frequently due to a congenital failure of the maxillary and median nasal processes to fuse. Cleft palate is characterized by a grooved depression or fissure in the roof of the mouth, most often resulting from a congenital failure of the palate to fuse properly. Clefts of the lip and palate can occur individually or together. It is preferable to code each defect separately. Evidence: TAS. Frequency: Occasional (HP:0040283). (ORPHA:63259)
- Hydrocephalus (HP:0000238): Hydrocephalus is an active distension of the ventricular system of the brain resulting from inadequate passage of CSF from its point of production within the cerebral ventricles to its point of absorption into the systemic circulation. Evidence: TAS. Frequency: Occasional (HP:0040283). (ORPHA:63259)
- Cystic hygroma (HP:0000476): A cystic lymphatic lesion of the neck. Evidence: TAS. Frequency: Occasional (HP:0040283). (ORPHA:63259)
- Congenital diaphragmatic hernia (HP:0000776): The presence of a hernia of the diaphragm present at birth. Evidence: TAS. Frequency: Occasional (HP:0040283). (ORPHA:63259)
- Dandy-Walker malformation (HP:0001305): A congenital brain malformation typically characterized by incomplete formation of the cerebellar vermis, dilation of the fourth ventricle, and enlargement of the posterior fossa. In layman's terms, Dandy Walker malformation is a cyst in the cerebellum (typically symmetrical) that is involved with the fourth ventricle. This may interfere with the ability to drain cerebrospinal fluid from the brain, resulting in hydrocephalus. Dandy Walker cysts are formed during early embryonic development, while the brain forms. The cyst in the cerebellum typically has several blood vessels running through it connecting to the brain, thereby prohibiting surgical removal. Evidence: TAS. Frequency: Occasional (HP:0040283). (ORPHA:63259)
- Lissencephaly (HP:0001339): A spectrum of malformations of cortical development caused by insufficient neuronal migration that subsumes the terms agyria, pachygyria and subcortical band heterotopia. See also neuropathological definitions for 2-, 3-, and 4-layered lissencephaly. Evidence: TAS. Frequency: Occasional (HP:0040283). (ORPHA:63259)
- Omphalocele (HP:0001539): A midline anterior incomplete closure of the abdominal wall in which there is herniation of the abdominal viscera into the base of the abdominal cord. Evidence: TAS. Frequency: Occasional (HP:0040283). (ORPHA:63259)
- Talipes equinovarus (HP:0001762): Talipes equinovarus (also called clubfoot) typically has four main components: inversion and adduction of the forefoot; inversion of the heel and hindfoot; equinus (limitation of extension) of the ankle and subtalar joint; and internal rotation of the leg. Evidence: TAS. Frequency: Occasional (HP:0040283). (ORPHA:63259)
- Anal atresia (HP:0002023): Congenital absence of the anus, i.e., the opening at the bottom end of the intestinal tract. Evidence: TAS. Frequency: Occasional (HP:0040283). (ORPHA:63259)
- Encephalocele (HP:0002084): A neural tube defect characterized by sac-like protrusions of the brain and the membranes that cover it through openings in the skull. Evidence: TAS. Frequency: Occasional (HP:0040283). (ORPHA:63259)
- Duodenal atresia (HP:0002247): A developmental defect resulting in complete obliteration of the duodenal lumen, that is, an abnormal closure of the duodenum. Evidence: TAS. Frequency: Occasional (HP:0040283). (ORPHA:63259)
- Myelomeningocele (HP:0002475): Protrusion of the meninges and portions of the spinal cord through a defect of the vertebral column. Evidence: TAS. Frequency: Occasional (HP:0040283). (ORPHA:63259)
- Arthrogryposis multiplex congenita (HP:0002804): Multiple congenital contractures in different body areas. Evidence: TAS. Frequency: Occasional (HP:0040283). (ORPHA:63259)
- Syringomyelia (HP:0003396): Dilated, glial-lined cavity in spinal cord. This cavity does not communicate with the central canal, and usually is between the dorsal columns unilaterally or bilaterally along the side of the cord. Evidence: TAS. Frequency: Occasional (HP:0040283). (ORPHA:63259)
- Abnormal occipital bone morphology (HP:0012294): Abnormality of the occipital bone of the skull. Evidence: TAS. Frequency: Occasional (HP:0040283). (ORPHA:63259)
These phenotypes are associated with the disease Iniencephaly (ORPHA:63259).